Phenotypes associated with the disease cerebellar ataxia, intellectual disability, and dysequilibrium syndrome 2 (OMIM:610185):
- Abnormality of the neck (HP:0000464): An abnormality of the neck. Evidence: IEA. (OMIM:610185)
- Short foot (HP:0001773): A measured foot length that is more than 2 SD below the mean for a newborn of 27 - 41 weeks gestation, or foot that is less than the 3rd centile for individuals from birth to 16 years of age (objective). Alternatively, a foot that appears disproportionately short (subjective). Evidence: IEA. (OMIM:610185)
- Strabismus (HP:0000486): A misalignment of the eyes so that the visual axes deviate from bifoveal fixation. The classification of strabismus may be based on a number of features including the relative position of the eyes, whether the deviation is latent or manifest, intermittent or constant, concomitant or otherwise and according to the age of onset and the relevance of any associated refractive error. Evidence: IEA. (OMIM:610185)
- Dysmetria (HP:0001310): A type of ataxia characterized by the inability to carry out movements with the correct range and motion across the plane of more than one joint related to incorrect estimation of the distances required for targeted movements. Evidence: IEA. (OMIM:610185)
- Short stature (HP:0004322): A height below that which is expected according to age and gender norms. Although there is no universally accepted definition of short stature, many refer to "short stature" as height more than 2 standard deviations below the mean for age and gender (or below the 3rd percentile for age and gender dependent norms). Evidence: IEA. (OMIM:610185)
- Cerebellar atrophy (HP:0001272): Cerebellar atrophy is defined as a cerebellum with initially normal structures, in a posterior fossa with normal size, which displays enlarged fissures (interfolial spaces) in comparison to the foliae secondary to loss of tissue. Cerebellar atrophy implies irreversible loss of tissue and result from an ongoing progressive disease until a final stage is reached or a single injury, e.g. an intoxication or infectious event. Evidence: PCS. Frequency: 2/2. (PMID:26437881)
- Gait ataxia (HP:0002066): A type of ataxia characterized by the impairment of the ability to coordinate the movements required for normal walking. Gait ataxia is characteirzed by a wide-based staggering gait with a tendency to fall. Evidence: PCS. Frequency: 1/2. (PMID:26437881)
- Global brain atrophy (HP:0002283): Unlocalized atrophy of the brain with decreased total brain matter volume and increased ventricular size. Evidence: IEA. (OMIM:610185)
- Ataxia (HP:0001251): Ataxia refers to impaired coordination of voluntary muscle movement. Cerebellar ataxia refers to ataxia due to dysfunction of the cerebellum. This causes a variety of elementary neurological deficits including asynergy (lack of coordination between muscles, limbs and joints), dysmetria (lack of ability to judge distances that can lead to under- or overshoot in grasping movements), and dysdiadochokinesia (inability to perform rapid movements requiring antagonizing muscle groups to be switched on and off repeatedly). Evidence: PCS. Frequency: 1/2. (PMID:26437881)
- Infantile onset (HP:0003593): Onset of signs or symptoms of disease between 28 days to one year of life. Evidence: PCS. Frequency: 2/2. (PMID:26437881)
- Coarse facial features (HP:0000280): Absence of fine and sharp appearance of brows, nose, lips, mouth, and chin, usually because of rounded and heavy features or thickened skin with or without thickening of subcutaneous and bony tissues. Evidence: IEA. (OMIM:610185)
- Intention tremor (HP:0002080): A type of kinetic tremor that occurs during target directed movement is called intention tremor. That is, an oscillatory cerebellar ataxia that tends to be absent when the limbs are inactive and during the first part of voluntary movement but worsening as the movement continues and greater precision is required (e.g., in touching a target such as the patient's nose or a physician's finger). Evidence: PCS. Frequency: 1/2. (PMID:26437881)
- Severe intellectual disability (HP:0010864): Severe intellectual disability (ID) is defined as a type of ID characterized by severely sub-average adaptive functioning and intellectual functioning, with an intelligence quotient (IQ) the range of 20-34. Evidence: TAS. (OMIM:610185)
- Aplasia of the inferior half of the cerebellar vermis (HP:0007063). Evidence: IEA. (OMIM:610185)
- Atrophy of the dentate nucleus (HP:0007047): Partial or complete wasting (loss) of dentate nucleus. Evidence: IEA. (OMIM:610185)
- Hirsutism (HP:0001007): Abnormally increased hair growth referring to a male pattern of body hair (androgenic hair). Evidence: IEA. (OMIM:610185)
- Intellectual disability (HP:0001249): The term intellectual disability or intellectual developmental disorder is used to describe significantly sub-average intellectual and adaptive functioning based on clinical assessment and as measured by individually administered, appropriately normed, standardized and validated tests of intellectual functioning and adaptive behavior, with onset during the developmental period from infancy through adolescence. Evidence: IEA. (OMIM:610185)
- Hyporeflexia (HP:0001265): Reduction of neurologic reflexes such as the knee-jerk reaction. Evidence: IEA. (OMIM:610185)
- Broad-based gait (HP:0002136): An abnormal gait pattern in which persons stand and walk with their feet spaced widely apart. This is often a component of cerebellar ataxia. Evidence: PCS. Frequency: 1/2. (PMID:26437881)
- Delayed speech and language development (HP:0000750): A degree of language development that is significantly below the norm for a child of a specified age. Evidence: IEA. (OMIM:610185)
- Short palm (HP:0004279): Short palm. Evidence: IEA. (OMIM:610185)
- Truncal ataxia (HP:0002078): Truncal ataxia is a sign of ataxia characterized by instability of the trunk. It usually occurs during sitting. Evidence: TAS. (OMIM:610185)
- Cerebellar hypoplasia (HP:0001321): Cerebellar hypoplasia is a descriptive term implying a cerebellum with a reduced volume, but a normal shape and is stable over time. Evidence: IEA. (OMIM:610185)
- Delayed ability to walk (HP:0031936): A failure to achieve the ability to walk at an appropriate developmental stage. Most children learn to walk in a series of stages, and learn to walk short distances independently between 12 and 15 months. Evidence: PCS. Frequency: 1/2. (PMID:26437881)
- Hypoplasia of the corpus callosum (HP:0002079): Underdevelopment of the corpus callosum. Evidence: IEA. (OMIM:610185)
- Dysarthria (HP:0001260): Dysarthric speech is a general description referring to a neurological speech disorder characterized by poor articulation. Depending on the involved neurological structures, dysarthria may be further classified as spastic, flaccid, ataxic, hyperkinetic and hypokinetic, or mixed. Evidence: IEA. (OMIM:610185)
- Global developmental delay (HP:0001263): A delay in the achievement of motor or mental milestones in the domains of development of a child, including motor skills, speech and language, cognitive skills, and social and emotional skills. This term should only be used to describe children younger than five years of age. Evidence: PCS. Frequency: 2/2. (PMID:26437881)
- Dysdiadochokinesis (HP:0002075): A type of ataxia characterized by the impairment of the ability to perform rapidly alternating movements, such as pronating and supinating his or her hand on the dorsum of the other hand as rapidly as possible. Evidence: IEA. (OMIM:610185)
- Sensorineural hearing impairment (HP:0000407): A type of hearing impairment in one or both ears related to an abnormal functionality of the cochlear nerve. Evidence: PCS. Frequency: 1/2. (PMID:26437881)
- Autosomal recessive inheritance (HP:0000007): A mode of inheritance that is observed for traits related to a gene encoded on one of the autosomes (i.e., the human chromosomes 1-22) in which a trait manifests in individuals with two pathogenic alleles, either homozygotes (two copies of the same mutant allele) or compound heterozygotes (whereby each copy of a gene has a distinct mutant allele). Evidence: PCS. (PMID:21885617)
- Small hand (HP:0200055): Disproportionately small hand. Evidence: TAS. (OMIM:610185)
- Thoracic kyphosis (HP:0002942): Over curvature of the thoracic region, leading to a round back or if sever to a hump. Evidence: TAS. (OMIM:610185)
- Thoracic scoliosis (HP:0002943). Evidence: IEA. (OMIM:610185)
- Tremor (HP:0001337): An unintentional, oscillating to-and-fro muscle movement about a joint axis. Evidence: IEA. (OMIM:610185)